- Microcornea (HP:0000482): A congenital abnormality of the cornea in which the cornea and the anterior segment of the eye are smaller than normal. The horizontal diameter of the cornea does not reach 10 mm even in adulthood. Evidence: TAS. Frequency: Very frequent (HP:0040281). (ORPHA:1377)
- Cataract (HP:0000518): A cataract is an opacity or clouding that develops in the crystalline lens of the eye or in its capsule. Evidence: TAS. Frequency: Very frequent (HP:0040281). (ORPHA:1377)
- Myopia (HP:0000545): An abnormality of refraction characterized by the ability to see objects nearby clearly, while objects in the distance appear blurry. Evidence: TAS. Frequency: Frequent (HP:0040282). (ORPHA:1377)
- Iris coloboma (HP:0000612): A coloboma of the iris. Evidence: TAS. Frequency: Occasional (HP:0040283). (ORPHA:1377)
- Nystagmus (HP:0000639): Rhythmic, involuntary oscillations of one or both eyes related to abnormality in fixation, conjugate gaze, or vestibular mechanisms. Evidence: TAS. Frequency: Occasional (HP:0040283). (ORPHA:1377)
- Corneal dystrophy (HP:0001131): The term corneal dystrophy embraces a heterogenous group of bilateral genetically determined non-inflammatory corneal diseases that are restricted to the cornea. Evidence: TAS. Frequency: Occasional (HP:0040283). (ORPHA:1377)
- Corneal opacity (HP:0007957): A reduction of corneal clarity. Evidence: TAS. Frequency: Occasional (HP:0040283). (ORPHA:1377)
These phenotypes are associated with the disease Cataract-microcornea syndrome (ORPHA:1377).